Phenotypes associated with the disease cluster headache, familial (OMIM:119915):
- Cluster headache (HP:0012199): A type of headache characterized by repeated attacks of unilateral pain lasting 15 to 180 minutes and associated with local autonomic signs. Evidence: TAS. (OMIM:119915)
- Rhinorrhea (HP:0031417): Increased discharge of mucus from the nose. Evidence: IEA. (OMIM:119915)
- Pain (HP:0012531): An unpleasant sensory and emotional experience associated with actual or potential tissue damage, or described in terms of such damage. Evidence: TAS. (OMIM:119915)
- Edema (HP:0000969): An abnormal accumulation of fluid beneath the skin, or in one or more cavities of the body. Evidence: IEA. (OMIM:119915)
- Miosis (HP:0000616): Abnormal (non-physiological) constriction of the pupil. Evidence: IEA. (OMIM:119915)
- Ptosis (HP:0000508): The upper eyelid margin is positioned 3 mm or more lower than usual and covers the superior portion of the iris (objective); or, the upper lid margin obscures at least part of the pupil (subjective). Evidence: IEA. (OMIM:119915)
- Hyperhidrosis (HP:0000975): Abnormal excessive perspiration (sweating) despite the lack of appropriate stimuli like hot and humid weather. Evidence: IEA. (OMIM:119915)
- Agitation (HP:0000713): A state of excessive motor activity that is associated with mental distress or a feeling of substantial unease or inner tension. Distinguished from restlessness by the increased level of emotional distress and negative intensity of the experience. Agitation has a significant level of physical activity that is typically threatening to the self or others. Evidence: IEA. (OMIM:119915)
- Autosomal dominant inheritance (HP:0000006): A mode of inheritance that is observed for traits related to a gene encoded on one of the autosomes (i.e., the human chromosomes 1-22) in which a trait manifests in heterozygotes. In the context of medical genetics, an autosomal dominant disorder is caused when a single copy of the mutant allele is present. Males and females are affected equally, and can both transmit the disorder with a risk of 50% for each child of inheriting the mutant allele. Evidence: IEA. (OMIM:119915)